- Abnormal circulating immunoglobulin concentration (HP:0010701): An abnormal deviation from normal levels of immunoglobulins in blood. Evidence: IEA. (OMIM:111620)
This phenotype is associated with the disease #111620 RADIN BLOOD GROUP ANTIGEN; RD;;BLOOD GROUP--RADIN ANTIGEN (OMIM:111620).